Phenotypes associated with the disease Gemignani syndrome (ORPHA:2074):
- Abnormal testis morphology (HP:0000035): An anomaly of the testicle (the male gonad). Evidence: TAS. Frequency: Very frequent (HP:0040281). (ORPHA:2074)
- Sensorineural hearing impairment (HP:0000407): A type of hearing impairment in one or both ears related to an abnormal functionality of the cochlear nerve. Evidence: TAS. Frequency: Very frequent (HP:0040281). (ORPHA:2074)
- Delayed puberty (HP:0000823): Passing the age when puberty normally occurs with no physical or hormonal signs of the onset of puberty. Evidence: TAS. Frequency: Very frequent (HP:0040281). (ORPHA:2074)
- Hypopigmented skin patches (HP:0001053). Evidence: TAS. Frequency: Frequent (HP:0040282). (ORPHA:2074)
- Intellectual disability (HP:0001249): The term intellectual disability or intellectual developmental disorder is used to describe significantly sub-average intellectual and adaptive functioning based on clinical assessment and as measured by individually administered, appropriately normed, standardized and validated tests of intellectual functioning and adaptive behavior, with onset during the developmental period from infancy through adolescence. Evidence: TAS. Frequency: Frequent (HP:0040282). (ORPHA:2074)
- Ataxia (HP:0001251): Ataxia refers to impaired coordination of voluntary muscle movement. Cerebellar ataxia refers to ataxia due to dysfunction of the cerebellum. This causes a variety of elementary neurological deficits including asynergy (lack of coordination between muscles, limbs and joints), dysmetria (lack of ability to judge distances that can lead to under- or overshoot in grasping movements), and dysdiadochokinesia (inability to perform rapid movements requiring antagonizing muscle groups to be switched on and off repeatedly). Evidence: TAS. Frequency: Very frequent (HP:0040281). (ORPHA:2074)
- Hyperreflexia (HP:0001347): Hyperreflexia is the presence of hyperactive stretch reflexes of the muscles. Evidence: TAS. Frequency: Very frequent (HP:0040281). (ORPHA:2074)
- Skeletal muscle atrophy (HP:0003202): The presence of skeletal muscular atrophy (which is also known as amyotrophy). Evidence: TAS. Frequency: Very frequent (HP:0040281). (ORPHA:2074)
- EMG abnormality (HP:0003457): Abnormal results of investigations using electromyography (EMG). Evidence: TAS. Frequency: Very frequent (HP:0040281). (ORPHA:2074)
- Short stature (HP:0004322): A height below that which is expected according to age and gender norms. Although there is no universally accepted definition of short stature, many refer to "short stature" as height more than 2 standard deviations below the mean for age and gender (or below the 3rd percentile for age and gender dependent norms). Evidence: TAS. Frequency: Very frequent (HP:0040281). (ORPHA:2074)
- Hemiplegia/hemiparesis (HP:0004374): Loss of strength in the arm, leg, and sometimes face on one side of the body. Hemiplegia refers to a severe or complete loss of strength, whereas hemiparesis refers to a relatively mild loss of strength. Evidence: TAS. Frequency: Very frequent (HP:0040281). (ORPHA:2074)
- Impaired pain sensation (HP:0007328): Reduced ability to perceive painful stimuli. Evidence: TAS. Frequency: Very frequent (HP:0040281). (ORPHA:2074)
- Hypoplasia of penis (HP:0008736). Evidence: TAS. Frequency: Frequent (HP:0040282). (ORPHA:2074)